- Echolalia (HP:0010529, a Human Phenotype Ontology term): Echolalia is the automatic imitative repetition of sounds, words, or phrases in the absence of explicit awareness. The repeated words or phrases are typically odd or used in a non-social manner. These can be words or phrases that the affected individual has heard or invented. Evidence: IEA. (OMIM:137580)
- Sleep disturbance (HP:0002360, a Human Phenotype Ontology term): An abnormal pattern in the quality, quantity, or characteristics of sleep. Evidence: IEA. (OMIM:137580)
- Aggressive behavior (HP:0000718, a Human Phenotype Ontology term): Behavior or an act aimed at harming a person, animal, or physical property (e.g., acts of physical violence; shouting, swearing, and using harsh language; slashing someone's tires). Evidence: TAS. (OMIM:137580)
- Compulsive behaviors (HP:0000722, a Human Phenotype Ontology term): Behavior that consists of repetitive acts, characterized by the feeling that one "has to" perform them, while being aware that these acts are not in line with one's overall goal. Evidence: IEA. (OMIM:137580)
- Phonic tics (HP:0100035, a Human Phenotype Ontology term): Tics are defined as movements or sounds that resemble physiological motor behaviors, but are typically inopportune to social context and appear sudden, repetitive, and often exaggerated. Tic vocalizations commonly termed vocal or phonic tics may include any possible sound (eg, sniffing, coughing, throat clearing, whistling, or grunting), word, or sentence and are most commonly encountered within the spectrum of primary tic disorders, as Tourette syndrome. Evidence: IEA. (OMIM:137580)
- Attention deficit hyperactivity disorder (HP:0007018, a Human Phenotype Ontology term): Attention deficit hyperactivity disorder (ADHD) manifests at age 2-3 years or by first grade at the latest. The main symptoms are distractibility, impulsivity, hyperactivity, and often trouble organizing tasks and projects, difficulty going to sleep, and social problems from being aggressive, loud, or impatient. Evidence: IEA. (OMIM:137580)
- Autosomal dominant inheritance (HP:0000006, a Human Phenotype Ontology term): A mode of inheritance that is observed for traits related to a gene encoded on one of the autosomes (i.e., the human chromosomes 1-22) in which a trait manifests in heterozygotes. In the context of medical genetics, an autosomal dominant disorder is caused when a single copy of the mutant allele is present. Males and females are affected equally, and can both transmit the disorder with a risk of 50% for each child of inheriting the mutant allele. Evidence: IEA. (OMIM:137580)
- Self-mutilation (HP:0000742, a Human Phenotype Ontology term): Deliberate harm to one's body resulting in tissue damage, without a conscious intent to die. Evidence: IEA. (OMIM:137580)
- Motor tics (HP:0100034, a Human Phenotype Ontology term): Movement-based tics affecting discrete muscle groups. Evidence: TAS. (OMIM:137580)
These phenotypes are associated with the disease Tourette syndrome (OMIM:137580, an entry in Online Mendelian Inheritance in Man).